Phenotypes associated with the disease hydatidiform mole, recurrent, 2 (OMIM:614293):
- Hydatidiform mole (HP:0032192): Hydatidiform mole (HM) is an aberrant human pregnancy with absence of, or abnormal embryonic development, hydropic degeneration of chorionic villi, and excessive proliferation of the trophoblast. Evidence: PCS. Frequency: 3/3. (PMID:23232697)
- Autosomal recessive inheritance (HP:0000007): A mode of inheritance that is observed for traits related to a gene encoded on one of the autosomes (i.e., the human chromosomes 1-22) in which a trait manifests in individuals with two pathogenic alleles, either homozygotes (two copies of the same mutant allele) or compound heterozygotes (whereby each copy of a gene has a distinct mutant allele). Evidence: PCS. (PMID:23232697)